- Ascites (HP:0001541): Accumulation of fluid in the peritoneal cavity (between the layers of the peritoneum that lines the abdomen). Evidence: IEA. (OMIM:608115)
- Abnormality of the genitourinary system (HP:0000119): The presence of any abnormality of the genitourinary system. Evidence: IEA. (OMIM:608115)
- Nausea (HP:0002018): A sensation of unease in the stomach together with an urge to vomit. Evidence: IEA. (OMIM:608115)
- Autosomal dominant inheritance (HP:0000006): A mode of inheritance that is observed for traits related to a gene encoded on one of the autosomes (i.e., the human chromosomes 1-22) in which a trait manifests in heterozygotes. In the context of medical genetics, an autosomal dominant disorder is caused when a single copy of the mutant allele is present. Males and females are affected equally, and can both transmit the disorder with a risk of 50% for each child of inheriting the mutant allele. Evidence: IEA. (OMIM:608115)
- Abdominal pain (HP:0002027): An unpleasant sensation characterized by physical discomfort (such as pricking, throbbing, or aching) and perceived to originate in the abdomen. Evidence: IEA. (OMIM:608115)
These phenotypes are associated with the disease ovarian hyperstimulation syndrome (OMIM:608115).